- Middle age onset (HP:0003596): A type of adult onset with onset of symptoms at the age of 40 to 60 years. Evidence: PCS. Frequency: 1/4. (PMID:26553276)
- Babinski sign (HP:0003487): Upturning of the big toe (and sometimes fanning of the other toes) in response to stimulation of the sole of the foot. If the Babinski sign is present it can indicate damage to the corticospinal tract. Evidence: PCS. Frequency: 1/3. (PMID:26553276)
- Upper limb muscle weakness (HP:0003484): Weakness of the muscles of the arms. Evidence: PCS. Frequency: 0/8. (PMID:26553276)
- Lower limb hyperreflexia (HP:0002395): Increased intensity of the a reflex in the leg. Evidence: PCS. Frequency: 4/4. (PMID:26553276)
- Lower limb muscle weakness (HP:0007340): Weakness of the muscles of the legs. Evidence: PCS. Frequency: 4/4. (PMID:26553276)
- Young adult onset (HP:0011462): Onset of disease at the age of between 16 and 40 years. Evidence: PCS. Frequency: 3/4. (PMID:26553276)
- Lower limb amyotrophy (HP:0007210): Muscular atrophy affecting the lower limb. Evidence: PCS. Frequency: 1/4. (PMID:26553276)
- Autosomal recessive inheritance (HP:0000007): A mode of inheritance that is observed for traits related to a gene encoded on one of the autosomes (i.e., the human chromosomes 1-22) in which a trait manifests in individuals with two pathogenic alleles, either homozygotes (two copies of the same mutant allele) or compound heterozygotes (whereby each copy of a gene has a distinct mutant allele). Evidence: PCS. (PMID:26553276)
- Spastic paraplegia (HP:0001258): Complete loss of the ability to move the lower limbs accompanied by spasticity of the lower limbs. Evidence: PCS. Frequency: 4/4. (PMID:26553276)
- Slowly progressive (HP:0003677): Applies to a disease manifestation that only slowly increases in scope or severity over the course of time. Evidence: PCS. (PMID:26553276)
These phenotypes are associated with the disease hereditary spastic paraplegia 77 (OMIM:617046).